- Posteriorly rotated ears (HP:0000358): A type of abnormal location of the ears in which the position of the ears is characterized by posterior rotation (the superior part of the ears is rotated towards the back of the head, and the inferior part of the ears towards the front). Evidence: TAS. Frequency: Very frequent (HP:0040281). (ORPHA:1110)
- Narrow mouth (HP:0000160): Distance between the commissures of the mouth more than 2 SD below the mean. Alternatively, an apparently decreased width of the oral aperture (subjective). Evidence: TAS. Frequency: Very frequent (HP:0040281). (ORPHA:1110)
- Facial asymmetry (HP:0000324): An abnormal difference between the left and right sides of the face. Evidence: TAS. Frequency: Very frequent (HP:0040281). (ORPHA:1110)
- Triangular face (HP:0000325): Facial contour, as viewed from the front, triangular in shape, with breadth at the temples and tapering to a narrow chin. Evidence: TAS. Frequency: Very frequent (HP:0040281). (ORPHA:1110)
- Broad forehead (HP:0000337): Width of the forehead or distance between the frontotemporales is more than two standard deviations above the mean (objective); or apparently increased distance between the two sides of the forehead. Evidence: TAS. Frequency: Very frequent (HP:0040281). (ORPHA:1110)
- Macrotia (HP:0000400): Median longitudinal ear length greater than two standard deviations above the mean and median ear width greater than two standard deviations above the mean (objective); or, apparent increase in length and width of the pinna (subjective). Evidence: TAS. Frequency: Very frequent (HP:0040281). (ORPHA:1110)
- Prominent nasal bridge (HP:0000426): Anterior positioning of the nasal root in comparison to the usual positioning for age. Evidence: TAS. Frequency: Very frequent (HP:0040281). (ORPHA:1110)
- Convex nasal ridge (HP:0000444): Nasal ridge curving anteriorly to an imaginary line that connects the nasal root and tip. The nose appears often also prominent, and the columella low. Evidence: TAS. Frequency: Very frequent (HP:0040281). (ORPHA:1110)
- Downslanted palpebral fissures (HP:0000494): The palpebral fissure inclination is more than two standard deviations below the mean. Evidence: TAS. Frequency: Very frequent (HP:0040281). (ORPHA:1110)
- Carious teeth (HP:0000670): Caries is a multifactorial bacterial infection affecting the structure of the tooth. This term has been used to describe the presence of more than expected dental caries. Evidence: TAS. Frequency: Very frequent (HP:0040281). (ORPHA:1110)
- Intellectual disability (HP:0001249): The term intellectual disability or intellectual developmental disorder is used to describe significantly sub-average intellectual and adaptive functioning based on clinical assessment and as measured by individually administered, appropriately normed, standardized and validated tests of intellectual functioning and adaptive behavior, with onset during the developmental period from infancy through adolescence. Evidence: TAS. Frequency: Very frequent (HP:0040281). (ORPHA:1110)
- Overriding aorta (HP:0002623): An overriding aorta is a congenital heart defect where the aorta is positioned directly over a ventricular septal defect, instead of over the left ventricle. The result is that the aorta receives some blood from the right ventricle, which reduces the amount of oxygen in the blood. It is one of the four conditions of the Tetralogy of Fallot. The aortic root can be displaced toward the front (anteriorly) or directly above the septal defect, but it is always abnormally located to the right of the root of the pulmonary artery. The degree of override is quite variable, with 5-95% of the valve being connected to the right ventricle. Evidence: TAS. Frequency: Very frequent (HP:0040281). (ORPHA:1110)
- Downturned corners of mouth (HP:0002714): A morphological abnormality of the mouth in which the angle of the mouth is downturned. The oral commissures are positioned inferior to the midline labial fissure. Evidence: TAS. Frequency: Very frequent (HP:0040281). (ORPHA:1110)
- Abnormal aortic arch morphology (HP:0012303): An anomaly of the arch of aorta. Evidence: TAS. Frequency: Very frequent (HP:0040281). (ORPHA:1110)
- Microcephaly (HP:0000252): Head circumference below 2 standard deviations below the mean for age and gender. Evidence: TAS. Frequency: Frequent (HP:0040282). (ORPHA:1110)
- Arteriovenous malformation (HP:0100026): An anomalous configuration of blood vessels that shunts arterial blood directly into veins without passing through the capillaries. Evidence: TAS. Frequency: Frequent (HP:0040282). (ORPHA:1110)
- Mandibular prognathia (HP:0000303): Abnormal prominence of the chin related to increased length of the mandible. Evidence: TAS. Frequency: Occasional (HP:0040283). (ORPHA:1110)
- Atypical behavior (HP:0000708): Atypical behavior is an abnormality in a person's actions that can be controlled or modulated by the will of the individual. While abnormal behaviors can be difficult to control, they are distinct from other abnormal actions that cannot be affected by the individual's will. Evidence: TAS. Frequency: Occasional (HP:0040283). (ORPHA:1110)
- Hypotonia (HP:0001252): Hypotonia is an abnormally low muscle tone (the amount of tension or resistance to movement in a muscle). Even when relaxed, muscles have a continuous and passive partial contraction which provides some resistance to passive stretching. Hypotonia thus manifests as diminished resistance to passive stretching. Hypotonia is not the same as muscle weakness, although the two conditions can co-exist. Evidence: TAS. Frequency: Occasional (HP:0040283). (ORPHA:1110)
- Intrauterine growth retardation (HP:0001511): An abnormal restriction of fetal growth with fetal weight below the tenth percentile for gestational age. Evidence: TAS. Frequency: Occasional (HP:0040283). (ORPHA:1110)
- Genu varum (HP:0002970): A positional abnormality marked by outward bowing of the legs in which the knees stay wide apart when a person stands with the feet and ankles together. Evidence: TAS. Frequency: Occasional (HP:0040283). (ORPHA:1110)
- Abnormal hip bone morphology (HP:0003272): An abnormality of the hip bone. Evidence: TAS. Frequency: Occasional (HP:0040283). (ORPHA:1110)
- Hypoplasia of the zygomatic bone (HP:0010669): Underdevelopment of the zygomatic bone. That is, a reduction in size of the zygomatic bone, including the zygomatic process of the temporal bone of the skull, which forms part of the zygomatic arch. Evidence: TAS. Frequency: Occasional (HP:0040283). (ORPHA:1110)
These phenotypes are associated with the disease Aortic arch anomaly-facial dysmorphism-intellectual disability syndrome (ORPHA:1110).